Phenotypes associated with the disease Mulibrey nanism (ORPHA:2576):
- Macrocephaly (HP:0000256): Occipitofrontal (head) circumference greater than 97th centile compared to appropriate, age matched, sex-matched normal standards. Alternatively, a apparently increased size of the cranium. Evidence: TAS. Frequency: Very frequent (HP:0040281). (ORPHA:2576)
- Wide nasal bridge (HP:0000431): Increased breadth of the nasal bridge (and with it, the nasal root). Evidence: TAS. Frequency: Frequent (HP:0040282). (ORPHA:2576)
- Diminished deep tendon reflex (HP:0001315): A reduction (hyporeflexia) or complete absence (areflexia) of the involuntary muscle contraction normally elicited by a reflex stimulus, such as tapping a deep tendon. Evidence: TAS. Frequency: Very frequent (HP:0040281). (ORPHA:2576)
- Intrauterine growth retardation (HP:0001511): An abnormal restriction of fetal growth with fetal weight below the tenth percentile for gestational age. Evidence: TAS. Frequency: Very frequent (HP:0040281). (ORPHA:2576)
- Abnormally high-pitched voice (HP:0001620): A persistent (minutes to hours) abnormal increase in the pitch (frequency) of the voice for the context or social situation or significantly different from baseline of the individual. Evidence: TAS. Frequency: Very frequent (HP:0040281). (ORPHA:2576)
- Hepatomegaly (HP:0002240): Abnormally increased size of the liver. Evidence: TAS. Frequency: Frequent (HP:0040282). (ORPHA:2576)
- J-shaped sella turcica (HP:0002680): A deformity of the sella turcica whereby the sella extends further anterior than normal such that the anterior clinoid process appears to overhang it, giving the appearance of the letter J on imaging of the skull. Evidence: TAS. Frequency: Very frequent (HP:0040281). (ORPHA:2576)
- Short stature (HP:0004322): A height below that which is expected according to age and gender norms. Although there is no universally accepted definition of short stature, many refer to "short stature" as height more than 2 standard deviations below the mean for age and gender (or below the 3rd percentile for age and gender dependent norms). Evidence: TAS. Frequency: Very frequent (HP:0040281). (ORPHA:2576)
- Cachexia (HP:0004326): Severe weight loss, wasting of muscle, loss of appetite, and general debility related to a chronic disease. Evidence: TAS. Frequency: Very frequent (HP:0040281). (ORPHA:2576)